Phenotypes associated with the disease myostatin-related muscle hypertrophy (OMIM:614160):
- Autosomal recessive inheritance (HP:0000007): A mode of inheritance that is observed for traits related to a gene encoded on one of the autosomes (i.e., the human chromosomes 1-22) in which a trait manifests in individuals with two pathogenic alleles, either homozygotes (two copies of the same mutant allele) or compound heterozygotes (whereby each copy of a gene has a distinct mutant allele). Evidence: PCS. (PMID:15215484)
- Skeletal muscle hypertrophy (HP:0003712): Abnormal increase in muscle size and mass not due to training. Evidence: PCS. Frequency: 1/1. Onset: Congenital onset (HP:0003577). (PMID:15215484)
- Brisk reflexes (HP:0001348): Tendon reflexes that are noticeably more active than usual (conventionally denoted 3+ on clinical examination). Brisk reflexes may or may not indicate a neurological lesion. They are distinguished from hyperreflexia by the fact that hyerreflexia is characterized by hyperactive repeating (clonic) reflexes, which are considered to be always abnormal. Evidence: PCS. Frequency: 1/1. (PMID:15215484)